- Vesicoureteral reflux (HP:0000076): Abnormal (retrograde) movement of urine from the bladder into ureters or kidneys related to inadequacy of the valvular mechanism at the ureterovesicular junction or other causes. Evidence: IEA. (OMIM:314550)
- X-linked inheritance (HP:0001417): A mode of inheritance that is observed for traits related to a gene encoded on the X chromosome. Evidence: IEA. (OMIM:314550)
These phenotypes are associated with the disease vesicoureteral reflux, X-linked (OMIM:314550).